Phenotypes associated with the disease dysautonomia-like disorder (OMIM:224000):
- Abnormal autonomic nervous system physiology (HP:0012332): A functional abnormality of the autonomic nervous system. Evidence: IEA. (OMIM:224000)
- Peripheral neuropathy (HP:0009830): Peripheral neuropathy is a general term for any disorder of the peripheral nervous system. The main clinical features used to classify peripheral neuropathy are distribution, type (mainly demyelinating versus mainly axonal), duration, and course. Evidence: IEA. (OMIM:224000)
- Autosomal recessive inheritance (HP:0000007): A mode of inheritance that is observed for traits related to a gene encoded on one of the autosomes (i.e., the human chromosomes 1-22) in which a trait manifests in individuals with two pathogenic alleles, either homozygotes (two copies of the same mutant allele) or compound heterozygotes (whereby each copy of a gene has a distinct mutant allele). Evidence: IEA. (OMIM:224000)
- Intellectual disability (HP:0001249): The term intellectual disability or intellectual developmental disorder is used to describe significantly sub-average intellectual and adaptive functioning based on clinical assessment and as measured by individually administered, appropriately normed, standardized and validated tests of intellectual functioning and adaptive behavior, with onset during the developmental period from infancy through adolescence. Evidence: IEA. (OMIM:224000)